Phenotypes associated with the disease Spinocerebellar ataxia type 23 (ORPHA:101108):
- Hyperreflexia (HP:0001347): Hyperreflexia is the presence of hyperactive stretch reflexes of the muscles. Evidence: TAS. Frequency: Very frequent (HP:0040281). (ORPHA:101108)
- Gait ataxia (HP:0002066): A type of ataxia characterized by the impairment of the ability to coordinate the movements required for normal walking. Gait ataxia is characteirzed by a wide-based staggering gait with a tendency to fall. Evidence: TAS. Frequency: Very frequent (HP:0040281). (ORPHA:101108)
- Limb ataxia (HP:0002070): A kind of ataxia that affects movements of the extremities. Evidence: TAS. Frequency: Very frequent (HP:0040281). (ORPHA:101108)
- Progressive cerebellar ataxia (HP:0002073). Evidence: TAS. Frequency: Very frequent (HP:0040281). (ORPHA:101108)
- Slow saccadic eye movements (HP:0000514): An abnormally slow velocity of the saccadic eye movements. Evidence: TAS. Frequency: Frequent (HP:0040282). (ORPHA:101108)
- Dysarthria (HP:0001260): Dysarthric speech is a general description referring to a neurological speech disorder characterized by poor articulation. Depending on the involved neurological structures, dysarthria may be further classified as spastic, flaccid, ataxic, hyperkinetic and hypokinetic, or mixed. Evidence: TAS. Frequency: Frequent (HP:0040282). (ORPHA:101108)
- Dysmetria (HP:0001310): A type of ataxia characterized by the inability to carry out movements with the correct range and motion across the plane of more than one joint related to incorrect estimation of the distances required for targeted movements. Evidence: TAS. Frequency: Frequent (HP:0040282). (ORPHA:101108)
- Babinski sign (HP:0003487): Upturning of the big toe (and sometimes fanning of the other toes) in response to stimulation of the sole of the foot. If the Babinski sign is present it can indicate damage to the corticospinal tract. Evidence: TAS. Frequency: Frequent (HP:0040282). (ORPHA:101108)
- Impaired distal vibration sensation (HP:0006886): A decrease in the ability to perceive vibration in the distal portions of the limbs. Evidence: TAS. Frequency: Frequent (HP:0040282). (ORPHA:101108)
- Impaired proprioception (HP:0010831): A loss or impairment of the sensation of the relative position of parts of the body and joint position. Evidence: TAS. Frequency: Frequent (HP:0040282). (ORPHA:101108)